- Posteriorly rotated ears (HP:0000358): A type of abnormal location of the ears in which the position of the ears is characterized by posterior rotation (the superior part of the ears is rotated towards the back of the head, and the inferior part of the ears towards the front). Evidence: TAS. Frequency: Frequent (HP:0040282). (ORPHA:35107)
- Pachygyria (HP:0001302): Pachygyria is a malformation of cortical development with abnormally wide gyri with sulci 1,5-3 cm apart and abnormally thick cortex measuring more than 5 mm (radiological definition). See also neuropathological definitions for 2-, 3-, and 4-layered lissencephaly. Evidence: TAS. Frequency: Occasional (HP:0040283). (ORPHA:35107)
- Seizure (HP:0001250): A seizure is an intermittent abnormality of nervous system physiology characterized by a transient occurrence of signs and/or symptoms due to abnormal excessive or synchronous neuronal activity in the brain. Evidence: TAS. Frequency: Frequent (HP:0040282). (ORPHA:35107)
- Ventriculomegaly (HP:0002119): An increase in size of the ventricular system of the brain. Evidence: TAS. Frequency: Frequent (HP:0040282). (ORPHA:35107)
- Status epilepticus (HP:0002133): Status epilepticus is a type of prolonged seizure resulting either from the failure of the mechanisms responsible for seizure termination or from the initiation of mechanisms which lead to abnormally prolonged seizures (after time point t1). It is a condition that can have long-term consequences (after time point t2), including neuronal death, neuronal injury, and alteration of neuronal networks, depending on the type and duration of seizures. Evidence: TAS. Frequency: Frequent (HP:0040282). (ORPHA:35107)
- Short nose (HP:0003196): Distance from nasion to subnasale more than two standard deviations below the mean, or alternatively, an apparently decreased length from the nasal root to the nasal tip. Evidence: TAS. Frequency: Frequent (HP:0040282). (ORPHA:35107)
- Depressed nasal bridge (HP:0005280): Posterior positioning of the nasal root in relation to the overall facial profile for age. Evidence: TAS. Frequency: Frequent (HP:0040282). (ORPHA:35107)
- Large earlobe (HP:0009748): Increased volume of the earlobe, that is, abnormally prominent ear lobules. Evidence: TAS. Frequency: Frequent (HP:0040282). (ORPHA:35107)
- Ambiguous genitalia (HP:0000062): A genital phenotype that is not clearly assignable to a single gender. Ambiguous genitalia can be evaluated using the Prader scale: Prader 0: Normal female external genitalia. Prader 1: Female external genitalia with clitoromegaly. Prader 2: Clitoromegaly with partial labial fusion forming a funnel-shaped urogenital sinus. Prader 3: Increased phallic enlargement. Complete labioscrotal fusion forming a urogenital sinus with a single opening. Prader 4: Complete scrotal fusion with urogenital opening at the base or on the shaft of the phallus. Prader 5: Normal male external genitalia. The diagnosis of ambiguous genitalia is made for Prader 1-4. Evidence: TAS. Frequency: Occasional (HP:0040283). (ORPHA:35107)
- Renal agenesis (HP:0000104): Agenesis, that is, failure of the kidney to develop during embryogenesis and development. Evidence: TAS. Frequency: Occasional (HP:0040283). (ORPHA:35107)
- Hydrocephalus (HP:0000238): Hydrocephalus is an active distension of the ventricular system of the brain resulting from inadequate passage of CSF from its point of production within the cerebral ventricles to its point of absorption into the systemic circulation. Evidence: TAS. Frequency: Occasional (HP:0040283). (ORPHA:35107)
- Macrocephaly (HP:0000256): Occipitofrontal (head) circumference greater than 97th centile compared to appropriate, age matched, sex-matched normal standards. Alternatively, a apparently increased size of the cranium. Evidence: TAS. Frequency: Occasional (HP:0040283). (ORPHA:35107)
- Epicanthus (HP:0000286): A fold of skin starting above the medial aspect of the upper eyelid and arching downward to cover, pass in front of and lateral to the medial canthus. Evidence: TAS. Frequency: Occasional (HP:0040283). (ORPHA:35107)
- Downslanted palpebral fissures (HP:0000494): The palpebral fissure inclination is more than two standard deviations below the mean. Evidence: TAS. Frequency: Occasional (HP:0040283). (ORPHA:35107)
- Pachygyria (HP:0001302): Pachygyria is a malformation of cortical development with abnormally wide gyri with sulci 1,5-3 cm apart and abnormally thick cortex measuring more than 5 mm (radiological definition). See also neuropathological definitions for 2-, 3-, and 4-layered lissencephaly. Evidence: TAS. Frequency: Occasional (HP:0040283). (ORPHA:35107)
- Lissencephaly (HP:0001339): A spectrum of malformations of cortical development caused by insufficient neuronal migration that subsumes the terms agyria, pachygyria and subcortical band heterotopia. See also neuropathological definitions for 2-, 3-, and 4-layered lissencephaly. Evidence: TAS. Frequency: Occasional (HP:0040283). (ORPHA:35107)
- Patent ductus arteriosus (HP:0001643): In utero, the ductus arteriosus (DA) serves to divert ventricular output away from the lungs and toward the placenta by connecting the main pulmonary artery to the descending aorta. A patent ductus arteriosus (PDA) in the first 3 days of life is a physiologic shunt in healthy term and preterm newborn infants, and normally is substantially closed within about 24 hours after bith and completely closed after about three weeks. Failure of physiologcal closure is referred to a persistent or patent ductus arteriosus (PDA). Depending on the degree of left-to-right shunting, PDA can have clinical consequences. Evidence: TAS. Frequency: Occasional (HP:0040283). (ORPHA:35107)
- Splenomegaly (HP:0001744): Abnormal increased size of the spleen. Evidence: TAS. Frequency: Occasional (HP:0040283). (ORPHA:35107)
- Metatarsus adductus (HP:0001840): The metatarsals are deviated medially (tibially), that is, the bones in the front half of the foot bend or turn in toward the body. Evidence: TAS. Frequency: Occasional (HP:0040283). (ORPHA:35107)
- Talipes (HP:0001883): A deformity of foot and ankle that has different subtypes that are talipes equinovarus, talipes equinovalgus, talipes calcaneovarus and talipes calcaneovalgus. Evidence: TAS. Frequency: Occasional (HP:0040283). (ORPHA:35107)
- Frontal bossing (HP:0002007): Bilateral bulging of the lateral frontal bone prominences with relative sparing of the midline. Evidence: TAS. Frequency: Occasional (HP:0040283). (ORPHA:35107)
- Polymicrogyria (HP:0002126): Polymicrogyria is a congenital malformation of the cerebral cortex characterized by abnormal cortical layering (lamination) and an excessive number of small gyri (folds). Evidence: TAS. Frequency: Occasional (HP:0040283). (ORPHA:35107)
- Abnormality of neuronal migration (HP:0002269): An abnormality resulting from an anomaly of neuronal migration, i.e., of the process by which neurons travel from their origin to their final position in the brain. Evidence: TAS. Frequency: Occasional (HP:0040283). (ORPHA:35107)
- Abnormal cortical gyration (HP:0002536): An abnormality of the gyri (i.e., the ridges) of the cerebral cortex of the brain. Evidence: TAS. Frequency: Occasional (HP:0040283). (ORPHA:35107)
- Intestinal malrotation (HP:0002566): An abnormality of the intestinal rotation and fixation that normally occurs during the development of the gut. This can lead to volvulus, or twisting of the intestine that causes obstruction and necrosis. Evidence: TAS. Frequency: Occasional (HP:0040283). (ORPHA:35107)
- Cleft palate (HP:0000175): Cleft palate is a developmental defect of the palate resulting from a failure of fusion of the palatine processes and manifesting as a separation of the roof of the mouth (soft and hard palate). Evidence: TAS. Frequency: Very frequent (HP:0040281). (ORPHA:35107)
- Submucous cleft hard palate (HP:0000176): Hard-palate submucous clefts are characterized by bony defects in the midline of the bony palate that are covered by the mucous membrane of the roof of the mouth. It may be possible to detect a submucous cleft hard palate upon palpation as a notch in the bony palate. Evidence: TAS. Frequency: Very frequent (HP:0040281). (ORPHA:35107)
- Bifid uvula (HP:0000193): Uvula separated into two parts most easily seen at the tip. Evidence: TAS. Frequency: Very frequent (HP:0040281). (ORPHA:35107)
- Microcephaly (HP:0000252): Head circumference below 2 standard deviations below the mean for age and gender. Evidence: TAS. Frequency: Very frequent (HP:0040281). (ORPHA:35107)
- Retrognathia (HP:0000278): An abnormality in which the mandible is mislocalised posteriorly. Evidence: TAS. Frequency: Very frequent (HP:0040281). (ORPHA:35107)
- Micrognathia (HP:0000347): Developmental hypoplasia of the mandible. Evidence: TAS. Frequency: Very frequent (HP:0040281). (ORPHA:35107)
- Intellectual disability (HP:0001249): The term intellectual disability or intellectual developmental disorder is used to describe significantly sub-average intellectual and adaptive functioning based on clinical assessment and as measured by individually administered, appropriately normed, standardized and validated tests of intellectual functioning and adaptive behavior, with onset during the developmental period from infancy through adolescence. Evidence: TAS. Frequency: Very frequent (HP:0040281). (ORPHA:35107)
- Spasticity (HP:0001257): A motor disorder characterized by a velocity-dependent increase in tonic stretch reflexes with increased muscle tone, exaggerated (hyperexcitable) tendon reflexes. Evidence: TAS. Frequency: Very frequent (HP:0040281). (ORPHA:35107)
- Agenesis of corpus callosum (HP:0001274): Absence of the corpus callosum as a result of the failure of the corpus callosum to develop, which can be the result of a failure in any one of the multiple steps of callosal development including cellular proliferation and migration, axonal growth or glial patterning at the midline. Evidence: TAS. Frequency: Very frequent (HP:0040281). (ORPHA:35107)
- Hypertonia (HP:0001276): A condition in which there is increased muscle tone so that arms or legs, for example, are stiff and difficult to move. Evidence: TAS. Frequency: Very frequent (HP:0040281). (ORPHA:35107)
- Absent septum pellucidum (HP:0001331): Absence of the septum pellucidum (meaning translucent wall in Latin - SP), also known as the ventricle of Sylvius. The septum pellucidum is a thin, triangular double membrane separating the frontal horns of the right and left lateral ventricles of the brain. It extends between the anterior portion of the corpus callosum, and the body of the fornix and its width varies from 1.5 to 3.0 mm. Evidence: TAS. Frequency: Very frequent (HP:0040281). (ORPHA:35107)
- Failure to thrive (HP:0001508): Failure to thrive (FTT) refers to a child whose physical growth is substantially below the norm. Evidence: TAS. Frequency: Very frequent (HP:0040281). (ORPHA:35107)
- Growth delay (HP:0001510): A deficiency or slowing down of growth pre- and postnatally. Evidence: TAS. Frequency: Very frequent (HP:0040281). (ORPHA:35107)
- Intrauterine growth retardation (HP:0001511): An abnormal restriction of fetal growth with fetal weight below the tenth percentile for gestational age. Evidence: TAS. Frequency: Very frequent (HP:0040281). (ORPHA:35107)
- Rigidity (HP:0002063): Continuous involuntary sustained muscle contraction. When an affected muscle is passively stretched, the degree of resistance remains constant regardless of the rate at which the muscle is stretched. This feature helps to distinguish rigidity from muscle spasticity. Evidence: TAS. Frequency: Very frequent (HP:0040281). (ORPHA:35107)
- Severe short stature (HP:0003510): A severe degree of short stature, more than -4 SD from the mean corrected for age and sex. Evidence: TAS. Frequency: Very frequent (HP:0040281). (ORPHA:35107)
- Muscle stiffness (HP:0003552): A condition in which muscles cannot be moved quickly without accompanying pain or spasm. Evidence: TAS. Frequency: Very frequent (HP:0040281). (ORPHA:35107)
- Feeding difficulties (HP:0011968): Impaired ability to eat related to problems gathering food and getting ready to suck, chew, or swallow it. Evidence: TAS. Frequency: Very frequent (HP:0040281). (ORPHA:35107)
- Narrow mouth (HP:0000160): Distance between the commissures of the mouth more than 2 SD below the mean. Alternatively, an apparently decreased width of the oral aperture (subjective). Evidence: TAS. Frequency: Frequent (HP:0040282). (ORPHA:35107)
- Abnormal earlobe morphology (HP:0000363): An abnormality of the lobule of pinna. Evidence: TAS. Frequency: Frequent (HP:0040282). (ORPHA:35107)
- Abnormality of the nose (HP:0000366): An abnormality of the nose. Evidence: TAS. Frequency: Frequent (HP:0040282). (ORPHA:35107)
- Low-set ears (HP:0000369): Upper insertion of the ear to the scalp below an imaginary horizontal line drawn between the inner canthi of the eye and extending posteriorly to the ear. Evidence: TAS. Frequency: Frequent (HP:0040282). (ORPHA:35107)
- Strabismus (HP:0000486): A misalignment of the eyes so that the visual axes deviate from bifoveal fixation. The classification of strabismus may be based on a number of features including the relative position of the eyes, whether the deviation is latent or manifest, intermittent or constant, concomitant or otherwise and according to the age of onset and the relevance of any associated refractive error. Evidence: TAS. Frequency: Frequent (HP:0040282). (ORPHA:35107)
- Nystagmus (HP:0000639): Rhythmic, involuntary oscillations of one or both eyes related to abnormality in fixation, conjugate gaze, or vestibular mechanisms. Evidence: TAS. Frequency: Frequent (HP:0040282). (ORPHA:35107)
- Micromelia (HP:0002983): The presence of abnormally small extremities. Evidence: TAS. Frequency: Occasional (HP:0040283). (ORPHA:35107)
- Dermal atrophy (HP:0004334): Partial or complete wasting (atrophy) of the skin. Evidence: TAS. Frequency: Occasional (HP:0040283). (ORPHA:35107)
- Aplasia/Hypoplasia of the skin (HP:0008065). Evidence: TAS. Frequency: Occasional (HP:0040283). (ORPHA:35107)
- Renal hypoplasia/aplasia (HP:0008678): Absence or underdevelopment of the kidney. Evidence: TAS. Frequency: Occasional (HP:0040283). (ORPHA:35107)
- Anomalous pulmonary venous return (HP:0010772): A developmental defect characterized by abnormal connection of one or more pulmonary veins to the superior or inferior vena cava, the right atrium, or the coronary sinus, resulting in a left-to-right shunt of oxygenated blood. Evidence: TAS. Frequency: Occasional (HP:0040283). (ORPHA:35107)
- Increased bone mineral density (HP:0011001): An abnormal increase of bone mineral density, that is, of the amount of matter per cubic centimeter of bones which is often referred to as osteosclerosis. Osteosclerosis can be detected on radiological examination as an increased whiteness (density) of affected bones. Evidence: TAS. Frequency: Occasional (HP:0040283). (ORPHA:35107)
- Osteopetrosis (HP:0011002): Abnormally increased formation of dense trabecular bone tissue. Despite the increased density of bone tissue, osteopetrotic bones tend to be more fracture-prone than normal. Evidence: TAS. Frequency: Occasional (HP:0040283). (ORPHA:35107)
- Prominent forehead (HP:0011220): Forward prominence of the entire forehead, due to protrusion of the frontal bone. Evidence: TAS. Frequency: Occasional (HP:0040283). (ORPHA:35107)
These phenotypes are associated with the disease Desmosterolosis (ORPHA:35107).